- Autosomal recessive inheritance (HP:0000007): A mode of inheritance that is observed for traits related to a gene encoded on one of the autosomes (i.e., the human chromosomes 1-22) in which a trait manifests in individuals with two pathogenic alleles, either homozygotes (two copies of the same mutant allele) or compound heterozygotes (whereby each copy of a gene has a distinct mutant allele). Evidence: IEA. (OMIM:270350)
- Anosmia (HP:0000458): An inability to perceive odors. This is a general term describing inability to smell arising in any part of the process of smelling from absorption of odorants into the nasal mucous overlying the olfactory epithelium, diffusion to the cilia, binding to olfactory receptor sites, generation of action potentials in olfactory neurons, and perception of a smell. Evidence: TAS. (OMIM:270350)
These phenotypes are associated with the disease SKUNK N-BUTYLMERCAPTAN, INABILITY TO SMELL (OMIM:270350).